Phenotypes associated with the disease autosomal dominant nonsyndromic hearing loss 43 (OMIM:608394):
- Sensorineural hearing impairment (HP:0000407): A type of hearing impairment in one or both ears related to an abnormal functionality of the cochlear nerve. Evidence: TAS. (OMIM:608394)
- Tinnitus (HP:0000360): Tinnitus is an auditory perception that can be described as the experience of sound, in the ear or in the head, in the absence of external acoustic stimulation. Evidence: TAS. (OMIM:608394)
- Autosomal dominant inheritance (HP:0000006): A mode of inheritance that is observed for traits related to a gene encoded on one of the autosomes (i.e., the human chromosomes 1-22) in which a trait manifests in heterozygotes. In the context of medical genetics, an autosomal dominant disorder is caused when a single copy of the mutant allele is present. Males and females are affected equally, and can both transmit the disorder with a risk of 50% for each child of inheriting the mutant allele. Evidence: TAS. (OMIM:608394)